- Hallucinations (HP:0000738): Perceptions in a conscious and awake state that, in the absence of external stimuli, have qualities of real perception. These perceptions are vivid, substantial, and located in external objective space. Evidence: TAS. Frequency: Very frequent (HP:0040281). (ORPHA:293807)
- Abdominal pain (HP:0002027): An unpleasant sensation characterized by physical discomfort (such as pricking, throbbing, or aching) and perceived to originate in the abdomen. Evidence: TAS. Frequency: Very frequent (HP:0040281). (ORPHA:293807)
- Abnormal biliary tract morphology (HP:0012440): A structural abnormality of the biliary tree. Evidence: TAS. Frequency: Very frequent (HP:0040281). (ORPHA:293807)
- Dysuria (HP:0100518): Painful or difficult urination. Evidence: TAS. Frequency: Very frequent (HP:0040281). (ORPHA:293807)
These phenotypes are associated with the disease Ketamine-induced biliary dilatation (ORPHA:293807).